Phenotypes associated with the disease Subacute sclerosing leukoencephalitis (ORPHA:2806):
- Atypical behavior (HP:0000708): Atypical behavior is an abnormality in a person's actions that can be controlled or modulated by the will of the individual. While abnormal behaviors can be difficult to control, they are distinct from other abnormal actions that cannot be affected by the individual's will. Evidence: TAS. Frequency: Very frequent (HP:0040281). (ORPHA:2806)
- Mental deterioration (HP:0001268): Loss of previously present mental abilities, generally in adults. Evidence: TAS. Frequency: Very frequent (HP:0040281). (ORPHA:2806)
- Myoclonus (HP:0001336): Very brief, involuntary random muscular contractions occurring at rest, in response to sensory stimuli, or accompanying voluntary movements. Evidence: TAS. Frequency: Very frequent (HP:0040281). (ORPHA:2806)
- Depression (HP:0000716): Frequently experiencing feelings of being down, miserable, and/or hopeless; struggling to recover from these moods; having a pessimistic outlook on the future; feeling a pervasive sense of shame; having a low self-worth; experiencing thoughts of suicide and engaging in suicidal behavior. Evidence: TAS. Frequency: Frequent (HP:0040282). (ORPHA:2806)
- Dementia (HP:0000726): A loss of global cognitive ability of sufficient amount to interfere with normal social or occupational function. Dementia represents a loss of previously present cognitive abilities, generally in adults, and can affect memory, thinking, language, judgment, and behavior. Evidence: TAS. Frequency: Frequent (HP:0040282). (ORPHA:2806)
- Irritability (HP:0000737): An emotional state characterized by negative feelings of heightened frustration, annoyance, or feeling upset, often triggered by internal factors (e.g., fatigue, hunger, unfulfilled desires) or external factors (e.g., social or environmental challenges). Irritability may be unpredictable, and is accompanied by a lowered threshold for emotional reactivity and observable features (speech, facial expressions, or psychomotor activity). Evidence: TAS. Frequency: Frequent (HP:0040282). (ORPHA:2806)
- Hallucinations (HP:0000738): Perceptions in a conscious and awake state that, in the absence of external stimuli, have qualities of real perception. These perceptions are vivid, substantial, and located in external objective space. Evidence: TAS. Frequency: Frequent (HP:0040282). (ORPHA:2806)
- Delusion (HP:0000746): A delusion is a fixed false belief held despite evidence to the contrary. The term delusion broadly encompasses all false judgments that possess the following external characteristics to a significant, albeit unspecified, extent: (1) they are held with an exceptional level of conviction, accompanied by an unparalleled subjective certainty; (2) there is an inability to consider alternative experiences or compelling counter-arguments; (3) the content of the belief is impossible. Evidence: TAS. Frequency: Frequent (HP:0040282). (ORPHA:2806)
- Seizure (HP:0001250): A seizure is an intermittent abnormality of nervous system physiology characterized by a transient occurrence of signs and/or symptoms due to abnormal excessive or synchronous neuronal activity in the brain. Evidence: TAS. Frequency: Frequent (HP:0040282). (ORPHA:2806)
- Lethargy (HP:0001254): A state of fatigue, either physical or mental slowness and sluggishness, with difficulties in initiating or performing simple tasks. Distinguished from apathy which implies indifference and a lack of desire or interest in the task. A person with lethargy may have the desire, but not the energy to engage in personal or socially relevant tasks. Evidence: TAS. Frequency: Frequent (HP:0040282). (ORPHA:2806)
- Gait disturbance (HP:0001288): The term gait disturbance can refer to any disruption of the ability to walk. Evidence: TAS. Frequency: Frequent (HP:0040282). (ORPHA:2806)
- Dystonia (HP:0001332): An abnormally increased muscular tone that causes fixed abnormal postures. There is a slow, intermittent twisting motion that leads to exaggerated turning and posture of the extremities and trunk. Evidence: TAS. Frequency: Frequent (HP:0040282). (ORPHA:2806)
- Sleep disturbance (HP:0002360): An abnormal pattern in the quality, quantity, or characteristics of sleep. Evidence: TAS. Frequency: Frequent (HP:0040282). (ORPHA:2806)
- Loss of speech (HP:0002371). Evidence: TAS. Frequency: Frequent (HP:0040282). (ORPHA:2806)
- EEG with periodic complexes (HP:0010856): Periodically occurring generalized periodic complexes. Evidence: TAS. Frequency: Frequent (HP:0040282). (ORPHA:2806)
- EEG with periodic complexes (HP:0010856): Periodically occurring generalized periodic complexes. Evidence: TAS. Frequency: Frequent (HP:0040282). (ORPHA:2806)
- Abnormal autonomic nervous system physiology (HP:0012332): A functional abnormality of the autonomic nervous system. Evidence: TAS. Frequency: Frequent (HP:0040282). (ORPHA:2806)
- Chorioretinitis (HP:0012424): An inflammation of the choroid and retina. Evidence: TAS. Frequency: Frequent (HP:0040282). (ORPHA:2806)
- Brain atrophy (HP:0012444): Partial or complete wasting (loss) of brain tissue that was once present. Evidence: TAS. Frequency: Frequent (HP:0040282). (ORPHA:2806)
- Akinetic mutism (HP:0012672): The combined absence of spontaneous movement (akinesia) and speech (mutism). There may be eye movements consistent with visual tracking and the person may remember the events occurring at the time of the experience of stupor. Evidence: TAS. Frequency: Frequent (HP:0040282). (ORPHA:2806)
- Periventricular white matter hyperintensities (HP:0030891): Areas of brighter than expected signal on magnetic resonance imaging emanating from the cerebral white matter that surrounds the cerebral ventricles. Evidence: TAS. Frequency: Frequent (HP:0040282). (ORPHA:2806)
- Vegetative state (HP:0031358): The absence of wakefulness and consciousness, but in contrast to a coma, there is involuntary opening of the eyes and movements such as teeth grinding, yawning, or thrashing of the extremities. Evidence: TAS. Frequency: Frequent (HP:0040282). (ORPHA:2806)
- Motor regression (HP:0033044): Loss of previously achieved motor skills, as manifested by loss of developmental motor milestones. Evidence: TAS. Frequency: Frequent (HP:0040282). (ORPHA:2806)
- Anti-measles antibody positivity (HP:0430088): The presence of antibodies in the blood circulation that react against a component of measles virus. Evidence: TAS. Frequency: Frequent (HP:0040282). (ORPHA:2806)
- Visual loss (HP:0000572): Loss of visual acuity (implying that vision was better at a certain time point in life). Otherwise the term reduced visual acuity should be used (or a subclass of that). Evidence: TAS. Frequency: Occasional (HP:0040283). (ORPHA:2806)
- Retinal hemorrhage (HP:0000573): Bleeding located within the retina. Retinal hemorrhages range from the smallest dot and blot hemorrhage to massive sub-hyaloid hemorrhage. Evidence: TAS. Frequency: Occasional (HP:0040283). (ORPHA:2806)
- Papilledema (HP:0001085): Papilledema refers to edema (swelling) of the optic disc secondary to any factor which increases cerebral spinal fluid pressure. Evidence: TAS. Frequency: Occasional (HP:0040283). (ORPHA:2806)
- Ataxia (HP:0001251): Ataxia refers to impaired coordination of voluntary muscle movement. Cerebellar ataxia refers to ataxia due to dysfunction of the cerebellum. This causes a variety of elementary neurological deficits including asynergy (lack of coordination between muscles, limbs and joints), dysmetria (lack of ability to judge distances that can lead to under- or overshoot in grasping movements), and dysdiadochokinesia (inability to perform rapid movements requiring antagonizing muscle groups to be switched on and off repeatedly). Evidence: TAS. Frequency: Occasional (HP:0040283). (ORPHA:2806)
- Spasticity (HP:0001257): A motor disorder characterized by a velocity-dependent increase in tonic stretch reflexes with increased muscle tone, exaggerated (hyperexcitable) tendon reflexes. Evidence: TAS. Frequency: Occasional (HP:0040283). (ORPHA:2806)
- Abnormality of extrapyramidal motor function (HP:0002071): A neurological condition related to lesions of the basal ganglia leading to typical abnormalities including akinesia (inability to initiate changes in activity and perform volitional movements rapidly and easily), muscular rigidity (continuous contraction of muscles with constant resistance to passive movement), chorea (widespread arrhythmic movements of a forcible, rapid, jerky, and restless nature), athetosis (inability to sustain the muscles of the fingers, toes, or other group of muscles in a fixed position), and akathisia (inability to remain motionless). Evidence: TAS. Frequency: Occasional (HP:0040283). (ORPHA:2806)
- Ventriculomegaly (HP:0002119): An increase in size of the ventricular system of the brain. Evidence: TAS. Frequency: Occasional (HP:0040283). (ORPHA:2806)
- CSF pleocytosis (HP:0012229): An increased white blood cell count in the cerebrospinal fluid. Evidence: TAS. Frequency: Occasional (HP:0040283). (ORPHA:2806)
- Reduced brain N-acetyl aspartate level by MRS (HP:0012708): A decrease in the level of N-acetyl aspartate in the brain identified by magnetic resonance spectroscopy (MRS). Evidence: TAS. Frequency: Occasional (HP:0040283). (ORPHA:2806)
- Abnormal brain choline/creatine ratio by MRS (HP:0012709): A deviation from normal in the ratio of choline to creatine in the brain identified by magnetic resonance spectroscopy (MRS). Evidence: TAS. Frequency: Occasional (HP:0040283). (ORPHA:2806)
- Dyskinesia (HP:0100660): A movement disorder which consists of effects including diminished voluntary movements and the presence of involuntary movements. Evidence: TAS. Frequency: Occasional (HP:0040283). (ORPHA:2806)
- CSF oligoclonal immunoglobulin G bands (HP:6000397): Oligoclonal immunoglobulin G (IgG) bands (OCBs) are a useful diagnostic tool to detect a central humoral response. In particular, cerebrospinal fluid (CSF)-restricted OCBs represent a hallmark of multiple sclerosis (MS). Evidence: TAS. Frequency: Occasional (HP:0040283). (ORPHA:2806)